Phenotypes associated with the disease Cooper-Jabs syndrome (ORPHA:1488):
- Brachycephaly (HP:0000248): An abnormality of skull shape characterized by a decreased anterior-posterior diameter. That is, a cephalic index greater than 81%. Alternatively, an apparently shortened anteroposterior dimension (length) of the head compared to width. Evidence: TAS. Frequency: Very frequent (HP:0040281). (ORPHA:1488)
- Malar flattening (HP:0000272): Underdevelopment of the malar prominence of the jugal bone (zygomatic bone in mammals), appreciated in profile, frontal view, and/or by palpation. Evidence: TAS. Frequency: Very frequent (HP:0040281). (ORPHA:1488)
- Abnormality of the middle ear (HP:0000370): An abnormality of the middle ear. Evidence: TAS. Frequency: Very frequent (HP:0040281). (ORPHA:1488)
- Conductive hearing impairment (HP:0000405): An abnormality of vibrational conductance of sound to the inner ear leading to impairment of sensory perception of sound. Evidence: TAS. Frequency: Very frequent (HP:0040281). (ORPHA:1488)
- Atresia of the external auditory canal (HP:0000413): Absence or failure to form of the external auditory canal. Evidence: TAS. Frequency: Very frequent (HP:0040281). (ORPHA:1488)
- Anteverted nares (HP:0000463): Anteriorly-facing nostrils viewed with the head in the Frankfurt horizontal and the eyes of the observer level with the eyes of the subject. This gives the appearance of an upturned nose (upturned nasal tip). Evidence: TAS. Frequency: Very frequent (HP:0040281). (ORPHA:1488)
- Intellectual disability (HP:0001249): The term intellectual disability or intellectual developmental disorder is used to describe significantly sub-average intellectual and adaptive functioning based on clinical assessment and as measured by individually administered, appropriately normed, standardized and validated tests of intellectual functioning and adaptive behavior, with onset during the developmental period from infancy through adolescence. Evidence: TAS. Frequency: Very frequent (HP:0040281). (ORPHA:1488)
- Anteriorly placed anus (HP:0001545): Anterior malposition of the anus. Evidence: TAS. Frequency: Very frequent (HP:0040281). (ORPHA:1488)
- Ventricular septal defect (HP:0001629): A hole between the two bottom chambers (ventricles) of the heart. The defect is centered around the most superior aspect of the ventricular septum. Evidence: TAS. Frequency: Very frequent (HP:0040281). (ORPHA:1488)
- Frontal bossing (HP:0002007): Bilateral bulging of the lateral frontal bone prominences with relative sparing of the midline. Evidence: TAS. Frequency: Very frequent (HP:0040281). (ORPHA:1488)
- Proximal placement of thumb (HP:0009623): Proximal mislocalization of the thumb. Evidence: TAS. Frequency: Very frequent (HP:0040281). (ORPHA:1488)
- Strabismus (HP:0000486): A misalignment of the eyes so that the visual axes deviate from bifoveal fixation. The classification of strabismus may be based on a number of features including the relative position of the eyes, whether the deviation is latent or manifest, intermittent or constant, concomitant or otherwise and according to the age of onset and the relevance of any associated refractive error. Evidence: TAS. Frequency: Frequent (HP:0040282). (ORPHA:1488)
- Abnormal rib morphology (HP:0000772): An anomaly of the rib. Evidence: TAS. Frequency: Frequent (HP:0040282). (ORPHA:1488)
- Congenital diaphragmatic hernia (HP:0000776): The presence of a hernia of the diaphragm present at birth. Evidence: TAS. Frequency: Frequent (HP:0040282). (ORPHA:1488)
- Missing ribs (HP:0000921): A developmental anomaly with absence of one or more ribs. Evidence: TAS. Frequency: Frequent (HP:0040282). (ORPHA:1488)
- Hypotonia (HP:0001252): Hypotonia is an abnormally low muscle tone (the amount of tension or resistance to movement in a muscle). Even when relaxed, muscles have a continuous and passive partial contraction which provides some resistance to passive stretching. Hypotonia thus manifests as diminished resistance to passive stretching. Hypotonia is not the same as muscle weakness, although the two conditions can co-exist. Evidence: TAS. Frequency: Frequent (HP:0040282). (ORPHA:1488)
- Umbilical hernia (HP:0001537): Protrusion of abdominal contents through a defect in the abdominal wall musculature around the umbilicus. Skin and subcutaneous tissue overlie the defect. Evidence: TAS. Frequency: Frequent (HP:0040282). (ORPHA:1488)
- Respiratory insufficiency (HP:0002093). Evidence: TAS. Frequency: Frequent (HP:0040282). (ORPHA:1488)
- Scoliosis (HP:0002650): The presence of an abnormal lateral curvature of the spine. Evidence: TAS. Frequency: Frequent (HP:0040282). (ORPHA:1488)
- Abnormal hip bone morphology (HP:0003272): An abnormality of the hip bone. Evidence: TAS. Frequency: Frequent (HP:0040282). (ORPHA:1488)
- Short stature (HP:0004322): A height below that which is expected according to age and gender norms. Although there is no universally accepted definition of short stature, many refer to "short stature" as height more than 2 standard deviations below the mean for age and gender (or below the 3rd percentile for age and gender dependent norms). Evidence: TAS. Frequency: Frequent (HP:0040282). (ORPHA:1488)
- Reduced bone mineral density (HP:0004349): A reduction of bone mineral density, that is, of the amount of matter per cubic centimeter of bones. Evidence: TAS. Frequency: Frequent (HP:0040282). (ORPHA:1488)
- Abnormal dermatoglyphics (HP:0007477): An abnormality of dermatoglyphs (fingerprints), which are present on fingers, palms, toes, and soles. Evidence: TAS. Frequency: Frequent (HP:0040282). (ORPHA:1488)
- Camptodactyly of finger (HP:0100490): The distal interphalangeal joint and/or the proximal interphalangeal joint of the fingers cannot be extended to 180 degrees by either active or passive extension. Evidence: TAS. Frequency: Frequent (HP:0040282). (ORPHA:1488)
- Joint hypermobility (HP:0001382): The capability that a joint (or a group of joints) has to move, passively and/or actively, beyond normal limits along physiological axes. Evidence: TAS. Frequency: Frequent (HP:0040282). (ORPHA:1488)
- Posteriorly rotated ears (HP:0000358): A type of abnormal location of the ears in which the position of the ears is characterized by posterior rotation (the superior part of the ears is rotated towards the back of the head, and the inferior part of the ears towards the front). Evidence: TAS. Frequency: Very frequent (HP:0040281). (ORPHA:1488)